- Low anterior hairline (HP:0000294): Distance between the hairline (trichion) and the glabella (the most prominent point on the frontal bone above the root of the nose), in the midline, more than two SD below the mean. Alternatively, an apparently decreased distance between the hairline and the glabella. Evidence: TAS. Frequency: Frequent (HP:0040282). (ORPHA:411986)
- Broad nasal tip (HP:0000455): Increase in width of the nasal tip. Evidence: TAS. Frequency: Frequent (HP:0040282). (ORPHA:411986)
- Anteverted nares (HP:0000463): Anteriorly-facing nostrils viewed with the head in the Frankfurt horizontal and the eyes of the observer level with the eyes of the subject. This gives the appearance of an upturned nose (upturned nasal tip). Evidence: TAS. Frequency: Frequent (HP:0040282). (ORPHA:411986)
- Telecanthus (HP:0000506): Distance between the inner canthi more than two standard deviations above the mean (objective); or, apparently increased distance between the inner canthi. Evidence: TAS. Frequency: Frequent (HP:0040282). (ORPHA:411986)
- Periorbital fullness (HP:0000629): Increase in periorbital soft tissue. Evidence: TAS. Frequency: Frequent (HP:0040282). (ORPHA:411986)
- Reduced eye contact (HP:0000817): A reduced frequency or duration of eye contact. Evidence: TAS. Frequency: Frequent (HP:0040282). (ORPHA:411986)
- Intellectual disability (HP:0001249): The term intellectual disability or intellectual developmental disorder is used to describe significantly sub-average intellectual and adaptive functioning based on clinical assessment and as measured by individually administered, appropriately normed, standardized and validated tests of intellectual functioning and adaptive behavior, with onset during the developmental period from infancy through adolescence. Evidence: TAS. Frequency: Frequent (HP:0040282). (ORPHA:411986)
- Hypoplasia of the corpus callosum (HP:0002079): Underdevelopment of the corpus callosum. Evidence: TAS. Frequency: Frequent (HP:0040282). (ORPHA:411986)
- Poor speech (HP:0002465). Evidence: TAS. Frequency: Frequent (HP:0040282). (ORPHA:411986)
- Generalized tonic seizure (HP:0010818): A generalized tonic seizure is a type of generalized motor seizure characterized by bilateral limb stiffening or elevation, often with neck stiffening without a subsequent clonic phase. The tonic activity can be a sustained abnormal posture, either in extension or flexion, sometimes accompanied by tremor of the extremities. Evidence: TAS. Frequency: Frequent (HP:0040282). (ORPHA:411986)
- Multifocal epileptiform discharges (HP:0010841): An abnormality in cerebral electrical activity recorded along the scalp by electroencephalography (EEG) and being identified at multiple locations (foci). Evidence: TAS. Frequency: Frequent (HP:0040282). (ORPHA:411986)
- Occipital cortical atrophy (HP:0012105): Atrophy of the occipital cortex. Evidence: TAS. Frequency: Frequent (HP:0040282). (ORPHA:411986)
- Hypoplasia of the pons (HP:0012110): Underdevelopment of the pons. Evidence: TAS. Frequency: Frequent (HP:0040282). (ORPHA:411986)
- Cerebral visual impairment (HP:0100704): A form of loss of vision caused by damage to the visual cortex rather than a defect in the eye. Evidence: TAS. Frequency: Frequent (HP:0040282). (ORPHA:411986)
- Everted lower lip vermilion (HP:0000232): An abnormal configuration of the lower lip such that it is turned outward i.e., everted, with the Inner aspect of the lower lip vermilion (normally opposing the teeth) being visible in a frontal view. Evidence: TAS. Frequency: Occasional (HP:0040283). (ORPHA:411986)
- Short philtrum (HP:0000322): Distance between nasal base and midline upper lip vermilion border more than 2 SD below the mean. Alternatively, an apparently decreased distance between nasal base and midline upper lip vermilion border. Evidence: TAS. Frequency: Occasional (HP:0040283). (ORPHA:411986)
- Narrow forehead (HP:0000341): Width of the forehead or distance between the frontotemporales is more than two standard deviations below the mean (objective); or apparently narrow intertemporal region (subjective). Evidence: TAS. Frequency: Occasional (HP:0040283). (ORPHA:411986)
- Bulbous nose (HP:0000414): Increased volume and globular shape of the anteroinferior aspect of the nose. Evidence: TAS. Frequency: Occasional (HP:0040283). (ORPHA:411986)
- Prominent nasal bridge (HP:0000426): Anterior positioning of the nasal root in comparison to the usual positioning for age. Evidence: TAS. Frequency: Occasional (HP:0040283). (ORPHA:411986)
- Long eyelashes (HP:0000527): Mid upper eyelash length >10 mm or increased length of the eyelashes (subjective). Evidence: TAS. Frequency: Occasional (HP:0040283). (ORPHA:411986)
- Anophthalmia (HP:0000528): Absence of the globe or eyeball. Evidence: TAS. Frequency: Occasional (HP:0040283). (ORPHA:411986)
- Thick eyebrow (HP:0000574): Increased density/number and/or increased diameter of eyebrow hairs. Evidence: TAS. Frequency: Occasional (HP:0040283). (ORPHA:411986)
- Synophrys (HP:0000664): Meeting of the medial eyebrows in the midline. Evidence: TAS. Frequency: Occasional (HP:0040283). (ORPHA:411986)
- Motor stereotypy (HP:0000733): Use of the same abnormal action in response to certain triggers or at random. They may be used as a way to regulate one's internal state but must otherwise have no apparent functional purpose. Evidence: TAS. Frequency: Occasional (HP:0040283). (ORPHA:411986)
- Hypotonia (HP:0001252): Hypotonia is an abnormally low muscle tone (the amount of tension or resistance to movement in a muscle). Even when relaxed, muscles have a continuous and passive partial contraction which provides some resistance to passive stretching. Hypotonia thus manifests as diminished resistance to passive stretching. Hypotonia is not the same as muscle weakness, although the two conditions can co-exist. Evidence: TAS. Frequency: Occasional (HP:0040283). (ORPHA:411986)
- Myoclonus (HP:0001336): Very brief, involuntary random muscular contractions occurring at rest, in response to sensory stimuli, or accompanying voluntary movements. Evidence: TAS. Frequency: Occasional (HP:0040283). (ORPHA:411986)
- Generalized non-motor (absence) seizure (HP:0002121): A generalized non-motor (absence) seizure is a type of a type of dialeptic seizure that is of electrographically generalized onset. It is a generalized seizure characterized by an interruption of activities, a blank stare, and usually the person will be unresponsive when spoken to. Any ictal motor phenomena are minor in comparison to these non-motor features. Evidence: TAS. Frequency: Occasional (HP:0040283). (ORPHA:411986)
- Focal impaired awareness seizure (HP:0002384): Focal impaired awareness seizure (or focal seizure with impaired or lost awareness) is a type of focal-onset seizure characterized by some degree (which may be partial) of impairment of the person's awareness of themselves or their surroundings at any point during the seizure. Evidence: TAS. Frequency: Occasional (HP:0040283). (ORPHA:411986)
- Hypsarrhythmia (HP:0002521): Hypsarrhythmia is abnormal interictal high amplitude waves and a background of irregular spikes. There is continuous (during wakefulness), high-amplitude (>200 Hz), generalized polymorphic slowing with no organized background and multifocal spikes demonstrated by electroencephalography (EEG). Evidence: TAS. Frequency: Occasional (HP:0040283). (ORPHA:411986)
- Inability to walk (HP:0002540): Incapability to ambulate. Evidence: TAS. Frequency: Occasional (HP:0040283). (ORPHA:411986)
- Large earlobe (HP:0009748): Increased volume of the earlobe, that is, abnormally prominent ear lobules. Evidence: TAS. Frequency: Occasional (HP:0040283). (ORPHA:411986)
- Prominent ear helix (HP:0009904): Abnormally prominent ear helix. Evidence: TAS. Frequency: Occasional (HP:0040283). (ORPHA:411986)
- Atonic seizure (HP:0010819): Atonic seizure is a type of motor seizure characterized by a sudden loss or diminution of muscle tone without apparent preceding myoclonic or tonic event lasting about 1 to 2 seconds, involving head, trunk, jaw, or limb musculature. Evidence: TAS. Frequency: Occasional (HP:0040283). (ORPHA:411986)
- Infantile spasms (HP:0012469): Infantile spasms represent a subset of "epileptic spasms". Infantile Spasms are epileptic spasms starting in the first year of life (infancy). Evidence: TAS. Frequency: Occasional (HP:0040283). (ORPHA:411986)
- Thick vermilion border (HP:0012471): Increased width of the skin of vermilion border region of upper lip. Evidence: TAS. Frequency: Occasional (HP:0040283). (ORPHA:411986)
- Abnormal spaced incisors (HP:0040159). Evidence: TAS. Frequency: Occasional (HP:0040283). (ORPHA:411986)
These phenotypes are associated with the disease Early-onset epileptic encephalopathy-cortical blindness-intellectual disability-facial dysmorphism syndrome (ORPHA:411986).